Phenotypes associated with the disease Congenital disorder of glycosylation, type 1bb  (OMIM:621567):
- Axial hypotonia (HP:0008936): Muscular hypotonia (abnormally low muscle tone) affecting the musculature of the trunk. Evidence: PCS. Frequency: 1/1. (PMID:27343064)
- Undetectable electroretinogram (HP:0000550): Lack of any response to stimulation upon electroretinography. Evidence: PCS. Frequency: 1/1. (PMID:27343064)
- Micropenis (HP:0000054): Abnormally small penis. At birth, the normal penis is about 3 cm (stretched length from pubic tubercle to tip of penis) with micropenis less than 2.0-2.5 cm. Evidence: PCS. Frequency: 1/1. (PMID:27343064)
- Elevated circulating aspartate aminotransferase concentration (HP:0031956): The concentration of aspartate aminotransferase (AST) in the blood circulation is above the upper limit of normal. Evidence: PCS. Frequency: 1/1. (PMID:27343064)
- Status epilepticus (HP:0002133): Status epilepticus is a type of prolonged seizure resulting either from the failure of the mechanisms responsible for seizure termination or from the initiation of mechanisms which lead to abnormally prolonged seizures (after time point t1). It is a condition that can have long-term consequences (after time point t2), including neuronal death, neuronal injury, and alteration of neuronal networks, depending on the type and duration of seizures. Evidence: PCS. Frequency: 1/1. (PMID:27343064)
- Bradycardia (HP:0001662): A slower than normal heart rate (in adults, slower than 60 beats per minute). Evidence: PCS. Frequency: 1/1. (PMID:27343064)
- Renal insufficiency (HP:0000083): A reduction in the level of performance of the kidneys in areas of function comprising the concentration of urine, removal of wastes, the maintenance of electrolyte balance, homeostasis of blood pressure, and calcium metabolism. Evidence: PCS. Frequency: 1/1. (PMID:27343064)
- Poor suck (HP:0002033): An inadequate sucking reflex, resulting in the difficult of newborns to be breast-fed. Evidence: PCS. Frequency: 1/1. (PMID:27343064)
- Global developmental delay (HP:0001263): A delay in the achievement of motor or mental milestones in the domains of development of a child, including motor skills, speech and language, cognitive skills, and social and emotional skills. This term should only be used to describe children younger than five years of age. Evidence: PCS. Frequency: 1/1. (PMID:27343064)
- Hepatomegaly (HP:0002240): Abnormally increased size of the liver. Evidence: PCS. Frequency: 1/1. (PMID:27343064)
- Elevated circulating alanine aminotransferase concentration (HP:0031964): An abnormally high concentration in the circulation of alanine aminotransferase (ALT). Evidence: PCS. Frequency: 1/1. (PMID:27343064)
- Failure to thrive (HP:0001508): Failure to thrive (FTT) refers to a child whose physical growth is substantially below the norm. Evidence: PCS. Frequency: 1/1. (PMID:27343064)
- Sensorineural hearing impairment (HP:0000407): A type of hearing impairment in one or both ears related to an abnormal functionality of the cochlear nerve. Evidence: PCS. Frequency: 1/1. (PMID:27343064)
- Small for gestational age (HP:0001518): Smaller than normal size according to sex and gestational age related norms, defined as a weight below the 10th percentile for the gestational age. Evidence: PCS. Frequency: 1/1. (PMID:27343064)
- Reduced eye contact (HP:0000817): A reduced frequency or duration of eye contact. Evidence: PCS. Frequency: 1/1. (PMID:27343064)
- Limb hypertonia (HP:0002509). Evidence: PCS. Frequency: 1/1. (PMID:27343064)
- Fetal onset (HP:0011461): Onset prior to birth but after 8 weeks of embryonic development (corresponding to a gestational age of 10 weeks). Evidence: PCS. Frequency: 1/1. (PMID:27343064)
- Decreased fetal movement (HP:0001558): An abnormal reduction in quantity or strength of fetal movements. Evidence: PCS. Frequency: 1/1. (PMID:27343064)
- Autosomal recessive inheritance (HP:0000007): A mode of inheritance that is observed for traits related to a gene encoded on one of the autosomes (i.e., the human chromosomes 1-22) in which a trait manifests in individuals with two pathogenic alleles, either homozygotes (two copies of the same mutant allele) or compound heterozygotes (whereby each copy of a gene has a distinct mutant allele). Evidence: PCS. (PMID:27343064)
- Intrauterine growth retardation (HP:0001511): An abnormal restriction of fetal growth with fetal weight below the tenth percentile for gestational age. Evidence: PCS. Frequency: 1/1. (PMID:27343064)
- Optic disc pallor (HP:0000543): A pale yellow discoloration of the optic disc (the area of the optic nerve head in the retina). The optic disc normally has a pinkish hue with a central yellowish depression. Evidence: PCS. Frequency: 1/1. (PMID:27343064)
- Cryptorchidism (HP:0000028): Testis in inguinal canal. That is, absence of one or both testes from the scrotum owing to failure of the testis or testes to descend through the inguinal canal to the scrotum. Evidence: PCS. Frequency: 1/1. (PMID:27343064)